Phenotypes associated with the disease persistent polyclonal B-cell lymphocytosis (OMIM:606445):
- Decreased circulating IgM concentration (HP:0002850): An abnormally decreased level of immunoglobulin M (IgM) in blood. Evidence: TAS. (OMIM:606445)
- Recurrent infections (HP:0002719): Increased susceptibility to infections as manifested by repeated bouts of infection. Evidence: TAS. (OMIM:606445)
- Hepatomegaly (HP:0002240): Abnormally increased size of the liver. Evidence: TAS. (OMIM:606445)
- Increased total lymphocyte count (HP:0100827): Increase in the number or proportion of lymphocytes in the blood. Evidence: IEA. (OMIM:606445)
- Splenomegaly (HP:0001744): Abnormal increased size of the spleen. Evidence: TAS. (OMIM:606445)
- Autosomal dominant inheritance (HP:0000006): A mode of inheritance that is observed for traits related to a gene encoded on one of the autosomes (i.e., the human chromosomes 1-22) in which a trait manifests in heterozygotes. In the context of medical genetics, an autosomal dominant disorder is caused when a single copy of the mutant allele is present. Males and females are affected equally, and can both transmit the disorder with a risk of 50% for each child of inheriting the mutant allele. Evidence: TAS. (OMIM:606445)